Phenotypes associated with the disease trichomegaly (OMIM:190330):
- Cataract (HP:0000518): A cataract is an opacity or clouding that develops in the crystalline lens of the eye or in its capsule. Evidence: IEA. (OMIM:190330)
- Autosomal recessive inheritance (HP:0000007): A mode of inheritance that is observed for traits related to a gene encoded on one of the autosomes (i.e., the human chromosomes 1-22) in which a trait manifests in individuals with two pathogenic alleles, either homozygotes (two copies of the same mutant allele) or compound heterozygotes (whereby each copy of a gene has a distinct mutant allele). Evidence: TAS. (OMIM:190330)
- Long eyelashes (HP:0000527): Mid upper eyelash length >10 mm or increased length of the eyelashes (subjective). Evidence: IEA. (OMIM:190330)